Phenotypes associated with the disease hearing loss, autosomal dominant 77 (OMIM:618915):
- Sensorineural hearing impairment (HP:0000407): A type of hearing impairment in one or both ears related to an abnormal functionality of the cochlear nerve. Evidence: PCS. Frequency: 13/13. Onset: Adult onset (HP:0003581). (PMID:31273342)
- Adult onset (HP:0003581): Onset of disease manifestations in adulthood, defined here as at the age of 16 years or later. Evidence: PCS. Frequency: 13/13. (PMID:31273342)
- Tinnitus (HP:0000360): Tinnitus is an auditory perception that can be described as the experience of sound, in the ear or in the head, in the absence of external acoustic stimulation. Evidence: PCS. Frequency: 0/13. (PMID:31273342)
- Abnormal inner ear morphology (HP:0011390): A structural anomaly of the internal part of the ear. Evidence: PCS. Frequency: 0/13. (PMID:31273342)
- Autosomal dominant inheritance (HP:0000006): A mode of inheritance that is observed for traits related to a gene encoded on one of the autosomes (i.e., the human chromosomes 1-22) in which a trait manifests in heterozygotes. In the context of medical genetics, an autosomal dominant disorder is caused when a single copy of the mutant allele is present. Males and females are affected equally, and can both transmit the disorder with a risk of 50% for each child of inheriting the mutant allele. Evidence: PCS. (PMID:31273342)